- Patellar hypoplasia (HP:0003065): Underdevelopment of the patella. Evidence: IEA. (OMIM:168860)
- Patellar aplasia (HP:0006443): Absence of the patella. Evidence: IEA. (OMIM:168860)
- Autosomal dominant inheritance (HP:0000006): A mode of inheritance that is observed for traits related to a gene encoded on one of the autosomes (i.e., the human chromosomes 1-22) in which a trait manifests in heterozygotes. In the context of medical genetics, an autosomal dominant disorder is caused when a single copy of the mutant allele is present. Males and females are affected equally, and can both transmit the disorder with a risk of 50% for each child of inheriting the mutant allele. Evidence: IEA. (OMIM:168860)
- Abnormality of the skin (HP:0000951): An abnormality of the skin. Evidence: IEA. (OMIM:168860)
These phenotypes are associated with the disease patella aplasia/hypoplasia (OMIM:168860).